- Abnormality of the immune system (HP:0002715): An abnormality of the immune system. Evidence: IEA. (OMIM:181460)
- Autosomal dominant inheritance (HP:0000006): A mode of inheritance that is observed for traits related to a gene encoded on one of the autosomes (i.e., the human chromosomes 1-22) in which a trait manifests in heterozygotes. In the context of medical genetics, an autosomal dominant disorder is caused when a single copy of the mutant allele is present. Males and females are affected equally, and can both transmit the disorder with a risk of 50% for each child of inheriting the mutant allele. Evidence: IEA. (OMIM:181460)
These phenotypes are associated with the disease Schistosoma mansoni infection, susceptibility/resistance to (OMIM:181460).